- Autosomal dominant inheritance (HP:0000006): A mode of inheritance that is observed for traits related to a gene encoded on one of the autosomes (i.e., the human chromosomes 1-22) in which a trait manifests in heterozygotes. In the context of medical genetics, an autosomal dominant disorder is caused when a single copy of the mutant allele is present. Males and females are affected equally, and can both transmit the disorder with a risk of 50% for each child of inheriting the mutant allele. Evidence: IEA. (OMIM:167950)
- Abnormality of the skin (HP:0000951): An abnormality of the skin. Evidence: IEA. (OMIM:167950)
These phenotypes are associated with the disease papillomatosis, florid, of nipple (OMIM:167950).